Phenotypes associated with the disease chondrosarcoma (OMIM:215300):
- Typified by somatic mosaicism (HP:0001442): Description of conditions in which affected individuals typically display somatic mosaicism, i.e., genetically distinct populations of somatic cells in a given organism caused by DNA mutations, epigenetic alterations of DNA, chromosomal abnormalities or the spontaneous reversion of inherited mutations. In many conditions typified by somatic mosaicism, constitutive mutation is lethal and cases are exclusively or predominantly mosaic. Evidence: TAS. (OMIM:215300)
- Chondrosarcoma (HP:0006765): A slowly growing malignant neoplasm derived from cartilage cells. Evidence: TAS. (OMIM:215300)